- Visual impairment (HP:0000505): Visual impairment (or vision impairment) is vision loss (of a person) to such a degree as to qualify as an additional support need through a significant limitation of visual capability resulting from either disease, trauma, or congenital or degenerative conditions that cannot be corrected by conventional means, such as refractive correction, medication, or surgery. Evidence: TAS. Frequency: Occasional (HP:0040283). (ORPHA:79292)
- Angina pectoris (HP:0001681): Paroxysmal chest pain that occurs with exertion or stress and is related to myocardial ischemia. Evidence: TAS. Frequency: Occasional (HP:0040283). (ORPHA:79292)
- Splenomegaly (HP:0001744): Abnormal increased size of the spleen. Evidence: TAS. Frequency: Occasional (HP:0040283). (ORPHA:79292)
- Hepatomegaly (HP:0002240): Abnormally increased size of the liver. Evidence: TAS. Frequency: Occasional (HP:0040283). (ORPHA:79292)
- Atherosclerosis (HP:0002621): A condition characterized by patchy atheromas or atherosclerotic plaques which develop in the walls of medium-sized and large arteries and can lead to arterial stenosis with reduced or blocked blood flow. Evidence: TAS. Frequency: Occasional (HP:0040283). (ORPHA:79292)
- Lymphadenopathy (HP:0002716): Enlargement (swelling) of a lymph node. Evidence: TAS. Frequency: Occasional (HP:0040283). (ORPHA:79292)
- Decreased circulating HDL-C concentration (HP:0003233): The concentration of high-density lipoprotein cholesterol in the blood circulation is below the lower limit of normal. Evidence: TAS. Frequency: Very frequent (HP:0040281). (ORPHA:79292)
- Corneal opacity (HP:0007957): A reduction of corneal clarity. Evidence: TAS. Frequency: Very frequent (HP:0040281). (ORPHA:79292)
These phenotypes are associated with the disease Fish-eye disease (ORPHA:79292).